Phenotypes associated with the disease tooth agenesis, selective, X-linked, 1 (OMIM:313500):
- Tooth agenesis (HP:0009804): The absence of one or more teeth from the normal series by a failure to develop. Evidence: PCS. (PMID:18657636)
- Agenesis of premolar (HP:0011051): Agenesis of premolar tooth. Evidence: PCS. Frequency: 9/10. Onset: Juvenile onset (HP:0003621). (PMID:16583127)
- Heat intolerance (HP:0002046): The inability to maintain a comfortable body temperature in warm or hot weather. Evidence: PCS. Frequency: 0/5. (PMID:18657636)
- Respiratory tract infection (HP:0011947): An infection of the upper or lower respiratory tract. Evidence: PCS. Frequency: 0/5. (PMID:18657636)
- Selective tooth agenesis (HP:0001592): Agenesis specifically affecting one of the classes incisor, premolar, or molar. Evidence: PCS. (PMID:18657636)
- Agenesis of molar (HP:0011054): Agenesis of molar tooth. Evidence: PCS. Frequency: 9/10. (PMID:16583127)
- Hypodontia (HP:0000668): The absence of five or less teeth from the normal series by a failure to develop. Evidence: PCS. Frequency: 5/5. (PMID:18657636)
- X-linked dominant inheritance (HP:0001423): A mode of inheritance that is observed for dominant traits related to a gene encoded on the X chromosome. In the context of medical genetics, X-linked dominant disorders tend to manifest very severely in affected males. The severity of manifestation in females may depend on the degree of skewed X inactivation. Evidence: PCS. (PMID:18657636)
- Agenesis of lateral incisor (HP:0200153). Evidence: PCS. Frequency: 5/5. (PMID:18657636)
- Anodontia (HP:0000674): The absence of all teeth from the normal series by a failure to develop. Evidence: PCS. (PMID:18657636)
- Oligodontia (HP:0000677): The absence of six or more teeth from the normal series by a failure to develop. Evidence: PCS. (PMID:18657636)
- Aplasia of the maxilla (HP:0010667): A congenital defect characterized by absence of the Maxilla. Evidence: PCS. Frequency: 5/5. (PMID:18657636)